- Epicanthus (HP:0000286): A fold of skin starting above the medial aspect of the upper eyelid and arching downward to cover, pass in front of and lateral to the medial canthus. Evidence: PCS. Frequency: 4/4. (PMID:27964749)
- Poor speech (HP:0002465). Evidence: PCS. Frequency: 1/4. (PMID:27964749)
- Narrow forehead (HP:0000341): Width of the forehead or distance between the frontotemporales is more than two standard deviations below the mean (objective); or apparently narrow intertemporal region (subjective). Evidence: PCS. Frequency: 1/4. (PMID:27964749)
- Upslanted palpebral fissure (HP:0000582): The palpebral fissure inclination is more than two standard deviations above the mean for age (objective); or, the inclination of the palpebral fissure is greater than typical for age. Evidence: PCS. Frequency: 2/4. (PMID:27964749)
- Congenital onset (HP:0003577): A phenotypic abnormality that is present at birth. Evidence: PCS. Frequency: 4/4. (PMID:27964749)
- Delayed CNS myelination (HP:0002188): Delayed myelination in the central nervous system. Evidence: PCS. Frequency: 1/4. (PMID:27964749)
- Hypermetropia (HP:0000540): An abnormality of refraction characterized by the ability to see objects in the distance clearly, while objects nearby appear blurry. Evidence: PCS. Frequency: 1/4. (PMID:27964749)
- Short stature (HP:0004322): A height below that which is expected according to age and gender norms. Although there is no universally accepted definition of short stature, many refer to "short stature" as height more than 2 standard deviations below the mean for age and gender (or below the 3rd percentile for age and gender dependent norms). Evidence: PCS. Frequency: 3/4. (PMID:27964749)
- Deep philtrum (HP:0002002): Accentuated, prominent philtral ridges giving rise to an exaggerated groove in the midline between the nasal base and upper vermillion border. Evidence: PCS. Frequency: 1/4. (PMID:27964749)
- Agenesis of corpus callosum (HP:0001274): Absence of the corpus callosum as a result of the failure of the corpus callosum to develop, which can be the result of a failure in any one of the multiple steps of callosal development including cellular proliferation and migration, axonal growth or glial patterning at the midline. Evidence: PCS. Frequency: 2/4. (PMID:27964749)
- Short palpebral fissure (HP:0012745): Distance between the medial and lateral canthi is more than 2 SD below the mean for age (objective); or, apparently reduced length of the palpebral fissures. Evidence: PCS. Frequency: 1/4. (PMID:27964749)
- Coarse facial features (HP:0000280): Absence of fine and sharp appearance of brows, nose, lips, mouth, and chin, usually because of rounded and heavy features or thickened skin with or without thickening of subcutaneous and bony tissues. Evidence: PCS. Frequency: 1/4. (PMID:27964749)
- Smooth philtrum (HP:0000319): Flat skin surface, with no ridge formation in the central region of the upper lip between the nasal base and upper vermilion border. Evidence: PCS. Frequency: 1/4. (PMID:27964749)
- Ventriculomegaly (HP:0002119): An increase in size of the ventricular system of the brain. Evidence: PCS. Frequency: 1/4. (PMID:27964749)
- Low hanging columella (HP:0009765): Columella extending inferior to the level of the nasal base, when viewed from the side. Evidence: PCS. Frequency: 1/4. (PMID:27964749)
- Patent ductus arteriosus (HP:0001643): In utero, the ductus arteriosus (DA) serves to divert ventricular output away from the lungs and toward the placenta by connecting the main pulmonary artery to the descending aorta. A patent ductus arteriosus (PDA) in the first 3 days of life is a physiologic shunt in healthy term and preterm newborn infants, and normally is substantially closed within about 24 hours after bith and completely closed after about three weeks. Failure of physiologcal closure is referred to a persistent or patent ductus arteriosus (PDA). Depending on the degree of left-to-right shunting, PDA can have clinical consequences. Evidence: PCS. Frequency: 1/4. (PMID:27964749)
- Wide intermamillary distance (HP:0006610): A larger than usual distance between the left and right nipple. Evidence: PCS. Frequency: 1/4. (PMID:27964749)
- Pes planus (HP:0001763): A foot where the longitudinal arch of the foot is in contact with the ground or floor when the individual is standing; or, in a patient lying supine, a foot where the arch is in contact with the surface of a flat board pressed against the sole of the foot by the examiner with a pressure similar to that expected from weight bearing; or, the height of the arch is reduced. Evidence: PCS. Frequency: 1/4. (PMID:27964749)
- Intellectual disability (HP:0001249): The term intellectual disability or intellectual developmental disorder is used to describe significantly sub-average intellectual and adaptive functioning based on clinical assessment and as measured by individually administered, appropriately normed, standardized and validated tests of intellectual functioning and adaptive behavior, with onset during the developmental period from infancy through adolescence. Evidence: PCS. (PMID:27964749)
- Posteriorly rotated ears (HP:0000358): A type of abnormal location of the ears in which the position of the ears is characterized by posterior rotation (the superior part of the ears is rotated towards the back of the head, and the inferior part of the ears towards the front). Evidence: PCS. Frequency: 1/4. (PMID:27964749)
- Renal dysplasia (HP:0000110): The presence of developmental dysplasia of the kidney. Evidence: PCS. Frequency: 2/3. (PMID:27964749)
- Wide mouth (HP:0000154): Distance between the oral commissures more than 2 SD above the mean. Alternatively, an apparently increased width of the oral aperture (subjective). Evidence: PCS. Frequency: 1/4. (PMID:27964749)
- Downslanted palpebral fissures (HP:0000494): The palpebral fissure inclination is more than two standard deviations below the mean. Evidence: PCS. Frequency: 1/4. (PMID:27964749)
- Microcephaly (HP:0000252): Head circumference below 2 standard deviations below the mean for age and gender. Evidence: PCS. Frequency: 2/4. (PMID:27964749)
- Talipes equinovarus (HP:0001762): Talipes equinovarus (also called clubfoot) typically has four main components: inversion and adduction of the forefoot; inversion of the heel and hindfoot; equinus (limitation of extension) of the ankle and subtalar joint; and internal rotation of the leg. Evidence: PCS. Frequency: 2/4. (PMID:27964749)
- Delayed ability to walk (HP:0031936): A failure to achieve the ability to walk at an appropriate developmental stage. Most children learn to walk in a series of stages, and learn to walk short distances independently between 12 and 15 months. Evidence: PCS. Frequency: 3/3. (PMID:27964749)
- Hypoplasia of the corpus callosum (HP:0002079): Underdevelopment of the corpus callosum. Evidence: PCS. Frequency: 1/4. (PMID:27964749)
- Colpocephaly (HP:0030048): Colpocephaly is an anatomic finding in the brain manifested by occipital horns that are disproportionately enlarged in comparison with other parts of the lateral ventricles. Evidence: PCS. Frequency: 1/4. (PMID:27964749)
- Feeding difficulties (HP:0011968): Impaired ability to eat related to problems gathering food and getting ready to suck, chew, or swallow it. Evidence: PCS. Frequency: 3/3. (PMID:27964749)
- Global developmental delay (HP:0001263): A delay in the achievement of motor or mental milestones in the domains of development of a child, including motor skills, speech and language, cognitive skills, and social and emotional skills. This term should only be used to describe children younger than five years of age. Evidence: PCS. Frequency: 3/3. (PMID:27964749)
- Coarctation of aorta (HP:0001680): Coarctation of the aorta is a narrowing or constriction of a segment of the aorta. Evidence: PCS. Frequency: 1/4. (PMID:27964749)
- EEG with burst suppression (HP:0010851): The burst suppression pattern in electroencephalography refers to a characteristic periodic pattern of low voltage (<10 microvolts) suppressed background and a relatively shorter pattern of higher amplitude slow, sharp, and spiking complexes. Evidence: PCS. Frequency: 1/4. (PMID:27964749)
- Respiratory insufficiency (HP:0002093). Evidence: PCS. Frequency: 3/4. Onset: Neonatal onset (HP:0003623). (PMID:27964749)
- Telecanthus (HP:0000506): Distance between the inner canthi more than two standard deviations above the mean (objective); or, apparently increased distance between the inner canthi. Evidence: PCS. Frequency: 1/4. (PMID:27964749)
- Mitral stenosis (HP:0001718): An abnormal narrowing of the orifice of the mitral valve. Evidence: PCS. Frequency: 1/4. (PMID:27964749)
- Renal cyst (HP:0000107): A fluid filled sac in the kidney. Evidence: PCS. Frequency: 2/3. (PMID:27964749)
- Decreased response to growth hormone stimulation test (HP:0000824): Insufficient responses to growth hormone (GH) provocation tests. GH deficiency is defined as a serum peak GH concentration less than 10 ng/mL on provocation with a combination of at least two separate stimulation tests. Evidence: PCS. Frequency: 1/4. (PMID:27964749)
- Pointed chin (HP:0000307): A marked tapering of the lower face to the chin. Evidence: PCS. Frequency: 2/4. (PMID:27964749)
- Neonatal hypotonia (HP:0001319): Muscular hypotonia (abnormally low muscle tone) manifesting in the neonatal period. Evidence: PCS. Frequency: 2/4. (PMID:27964749)
- Frontal bossing (HP:0002007): Bilateral bulging of the lateral frontal bone prominences with relative sparing of the midline. Evidence: PCS. Frequency: 2/4. (PMID:27964749)
- Autosomal dominant inheritance (HP:0000006): A mode of inheritance that is observed for traits related to a gene encoded on one of the autosomes (i.e., the human chromosomes 1-22) in which a trait manifests in heterozygotes. In the context of medical genetics, an autosomal dominant disorder is caused when a single copy of the mutant allele is present. Males and females are affected equally, and can both transmit the disorder with a risk of 50% for each child of inheriting the mutant allele. Evidence: PCS. (PMID:27964749)
- Triangular face (HP:0000325): Facial contour, as viewed from the front, triangular in shape, with breadth at the temples and tapering to a narrow chin. Evidence: PCS. Frequency: 2/4. (PMID:27964749)
- Low-set ears (HP:0000369): Upper insertion of the ear to the scalp below an imaginary horizontal line drawn between the inner canthi of the eye and extending posteriorly to the ear. Evidence: PCS. Frequency: 1/4. (PMID:27964749)
These phenotypes are associated with the disease global developmental delay, absent or hypoplastic corpus callosum, and dysmorphic facies (OMIM:617260).